- Hypoplasia of the ulna (HP:0003022): Underdevelopment of the ulna. Evidence: TAS. (OMIM:107900)
- Autosomal dominant inheritance (HP:0000006): A mode of inheritance that is observed for traits related to a gene encoded on one of the autosomes (i.e., the human chromosomes 1-22) in which a trait manifests in heterozygotes. In the context of medical genetics, an autosomal dominant disorder is caused when a single copy of the mutant allele is present. Males and females are affected equally, and can both transmit the disorder with a risk of 50% for each child of inheriting the mutant allele. Evidence: TAS. (OMIM:107900)
- Hypoplasia of the radius (HP:0002984): Underdevelopment of the radius. Evidence: TAS. (OMIM:107900)
- Radioulnar synostosis (HP:0002974): An abnormal osseous union (fusion) between the radius and the ulna. Evidence: TAS. (OMIM:107900)
These phenotypes are associated with the disease arms, malformation of (OMIM:107900).